- Focal cortical dysplasia type IIa (HP:0032052): A subtype of focal cortical dysplasia type II that is characterized by dysmorphic neurons, which present with a significantly enlarged cell body and nucleus, malorientation, abnormally distributed intracellular Nissl substance and cytoplasmic accumulation of neurofilament proteins. Evidence: IEA. Frequency: 3/6. (PMID:26285051)
- Seizure (HP:0001250): A seizure is an intermittent abnormality of nervous system physiology characterized by a transient occurrence of signs and/or symptoms due to abnormal excessive or synchronous neuronal activity in the brain. Evidence: IEA. (OMIM:617118)
- Typified by incomplete penetrance (HP:0003829): Description of conditions in which not all individuals with a given genotype exhibit the disease. Penetrance is the proportion that develop disease given a lifespan of 80 years. Evidence: TAS. (OMIM:617118)
- Focal cortical dysplasia (HP:0032046): A type of malformation of cortical development that primarily affects areas of neocortex. It can be identified on conventional magnetic resonance imaging as focal cortical thickening, abnormal gyration, and blurring between gray and white matter, often associated with clusters of heterotopic neurons. Evidence: PCS. Frequency: 2/15. (PMID:27173016)
- Autosomal dominant inheritance (HP:0000006): A mode of inheritance that is observed for traits related to a gene encoded on one of the autosomes (i.e., the human chromosomes 1-22) in which a trait manifests in heterozygotes. In the context of medical genetics, an autosomal dominant disorder is caused when a single copy of the mutant allele is present. Males and females are affected equally, and can both transmit the disorder with a risk of 50% for each child of inheriting the mutant allele. Evidence: TAS. (OMIM:617118)
These phenotypes are associated with the disease epilepsy, familial focal, with variable foci 3 (OMIM:617118).